- Recurrent mucocutaneous candidiasis (HP:0002728): Recurrent or persistent superficial Candida infections of the skin, mucous membranes, and nails. Evidence: PCS. (PMID:21350122)
- Autosomal dominant inheritance (HP:0000006): A mode of inheritance that is observed for traits related to a gene encoded on one of the autosomes (i.e., the human chromosomes 1-22) in which a trait manifests in heterozygotes. In the context of medical genetics, an autosomal dominant disorder is caused when a single copy of the mutant allele is present. Males and females are affected equally, and can both transmit the disorder with a risk of 50% for each child of inheriting the mutant allele. Evidence: PCS. (PMID:21350122)
These phenotypes are associated with the disease candidiasis, familial, 6 (OMIM:613956).